Phenotypes associated with the disease microcephaly-facio-cardio-skeletal syndrome, Hadziselimovic type (OMIM:612946):
- Epicanthus (HP:0000286): A fold of skin starting above the medial aspect of the upper eyelid and arching downward to cover, pass in front of and lateral to the medial canthus. Evidence: IEA. (OMIM:612946)
- Strabismus (HP:0000486): A misalignment of the eyes so that the visual axes deviate from bifoveal fixation. The classification of strabismus may be based on a number of features including the relative position of the eyes, whether the deviation is latent or manifest, intermittent or constant, concomitant or otherwise and according to the age of onset and the relevance of any associated refractive error. Evidence: IEA. (OMIM:612946)
- Anal atresia (HP:0002023): Congenital absence of the anus, i.e., the opening at the bottom end of the intestinal tract. Evidence: IEA. (OMIM:612946)
- Renal hypoplasia (HP:0000089): Hypoplasia of the kidney. Evidence: IEA. (OMIM:612946)
- Anteverted nares (HP:0000463): Anteriorly-facing nostrils viewed with the head in the Frankfurt horizontal and the eyes of the observer level with the eyes of the subject. This gives the appearance of an upturned nose (upturned nasal tip). Evidence: IEA. (OMIM:612946)
- Short stature (HP:0004322): A height below that which is expected according to age and gender norms. Although there is no universally accepted definition of short stature, many refer to "short stature" as height more than 2 standard deviations below the mean for age and gender (or below the 3rd percentile for age and gender dependent norms). Evidence: IEA. (OMIM:612946)
- Hypotonia (HP:0001252): Hypotonia is an abnormally low muscle tone (the amount of tension or resistance to movement in a muscle). Even when relaxed, muscles have a continuous and passive partial contraction which provides some resistance to passive stretching. Hypotonia thus manifests as diminished resistance to passive stretching. Hypotonia is not the same as muscle weakness, although the two conditions can co-exist. Evidence: IEA. (OMIM:612946)
- U-Shaped upper lip vermilion (HP:0010806): Gentle upward curve of the upper lip vermilion such that the center is placed well superior to the commissures. Evidence: IEA. (OMIM:612946)
- Generalized hypotonia (HP:0001290): Generalized muscular hypotonia (abnormally low muscle tone). Evidence: TAS. (OMIM:612946)
- Failure to thrive (HP:0001508): Failure to thrive (FTT) refers to a child whose physical growth is substantially below the norm. Evidence: IEA. (OMIM:612946)
- Ventricular septal defect (HP:0001629): A hole between the two bottom chambers (ventricles) of the heart. The defect is centered around the most superior aspect of the ventricular septum. Evidence: IEA. (OMIM:612946)
- High palate (HP:0000218): Height of the palate more than 2 SD above the mean (objective) or palatal height at the level of the first permanent molar more than twice the height of the teeth (subjective). Evidence: IEA. (OMIM:612946)
- Pulmonary artery atresia (HP:0004935): A congenital anomaly with a narrowing or complete absence of the opening between the right ventricle and the pulmonary artery. Evidence: IEA. (OMIM:612946)
- Thick lower lip vermilion (HP:0000179): Increased thickness of the lower lip, leading to a prominent appearance of the lower lip. The height of the vermilion of the lower lip in the midline is more than 2 SD above the mean. Alternatively, an apparently increased height of the vermilion of the lower lip in the frontal view (subjective). Evidence: IEA. (OMIM:612946)
- Abnormally high-pitched voice (HP:0001620): A persistent (minutes to hours) abnormal increase in the pitch (frequency) of the voice for the context or social situation or significantly different from baseline of the individual. Evidence: IEA. (OMIM:612946)
- Posteriorly rotated ears (HP:0000358): A type of abnormal location of the ears in which the position of the ears is characterized by posterior rotation (the superior part of the ears is rotated towards the back of the head, and the inferior part of the ears towards the front). Evidence: IEA. (OMIM:612946)
- Intellectual disability (HP:0001249): The term intellectual disability or intellectual developmental disorder is used to describe significantly sub-average intellectual and adaptive functioning based on clinical assessment and as measured by individually administered, appropriately normed, standardized and validated tests of intellectual functioning and adaptive behavior, with onset during the developmental period from infancy through adolescence. Evidence: IEA. (OMIM:612946)
- Microcephaly (HP:0000252): Head circumference below 2 standard deviations below the mean for age and gender. Evidence: IEA. (OMIM:612946)
- Absent speech (HP:0001344): Complete lack of development of speech and language abilities. Evidence: TAS. (OMIM:612946)
- Cerebellar hypoplasia (HP:0001321): Cerebellar hypoplasia is a descriptive term implying a cerebellum with a reduced volume, but a normal shape and is stable over time. Evidence: IEA. (OMIM:612946)
- Delayed skeletal maturation (HP:0002750): A decreased rate of skeletal maturation. Delayed skeletal maturation can be diagnosed on the basis of an estimation of the bone age from radiographs of specific bones in the human body. Evidence: IEA. (OMIM:612946)
- Hypoplasia of the corpus callosum (HP:0002079): Underdevelopment of the corpus callosum. Evidence: TAS. Frequency: Occasional (HP:0040283). (OMIM:612946)
- Global developmental delay (HP:0001263): A delay in the achievement of motor or mental milestones in the domains of development of a child, including motor skills, speech and language, cognitive skills, and social and emotional skills. This term should only be used to describe children younger than five years of age. Evidence: IEA. (OMIM:612946)
- Low anterior hairline (HP:0000294): Distance between the hairline (trichion) and the glabella (the most prominent point on the frontal bone above the root of the nose), in the midline, more than two SD below the mean. Alternatively, an apparently decreased distance between the hairline and the glabella. Evidence: IEA. (OMIM:612946)
- Ptosis (HP:0000508): The upper eyelid margin is positioned 3 mm or more lower than usual and covers the superior portion of the iris (objective); or, the upper lid margin obscures at least part of the pupil (subjective). Evidence: IEA. (OMIM:612946)
- Prominent nasal bridge (HP:0000426): Anterior positioning of the nasal root in comparison to the usual positioning for age. Evidence: IEA. (OMIM:612946)
- Tetralogy of Fallot (HP:0001636): A congenital cardiac malformation comprising pulmonary stenosis, overriding aorta, ventricular septum defect, and right ventricular hypertrophy. The diagnosis of TOF is made if at least three of the four above mentioned features are present. Evidence: IEA. (OMIM:612946)
- Autosomal recessive inheritance (HP:0000007): A mode of inheritance that is observed for traits related to a gene encoded on one of the autosomes (i.e., the human chromosomes 1-22) in which a trait manifests in individuals with two pathogenic alleles, either homozygotes (two copies of the same mutant allele) or compound heterozygotes (whereby each copy of a gene has a distinct mutant allele). Evidence: IEA. (OMIM:612946)
- Hypotelorism (HP:0000601): Interpupillary distance less than 2 SD below the mean (alternatively, the appearance of an decreased interpupillary distance or closely spaced eyes). Evidence: IEA. (OMIM:612946)
- Ventricular hypertrophy (HP:0001714): Enlargement of the cardiac ventricular muscle tissue with increase in the width of the wall of the ventricle and loss of elasticity. Ventricular hypertrophy is clinically differentiated into left and right ventricular hypertrophy. Evidence: IEA. (OMIM:612946)
- Atrial septal defect (HP:0001631): Atrial septal defect (ASD) is a congenital abnormality of the interatrial septum that enables blood flow between the left and right atria via the interatrial septum. Evidence: IEA. (OMIM:612946)
- Low-set ears (HP:0000369): Upper insertion of the ear to the scalp below an imaginary horizontal line drawn between the inner canthi of the eye and extending posteriorly to the ear. Evidence: IEA. (OMIM:612946)